Phenotypes associated with the disease juvenile myelomonocytic leukemia (OMIM:607785):
- Typified by somatic mosaicism (HP:0001442): Description of conditions in which affected individuals typically display somatic mosaicism, i.e., genetically distinct populations of somatic cells in a given organism caused by DNA mutations, epigenetic alterations of DNA, chromosomal abnormalities or the spontaneous reversion of inherited mutations. In many conditions typified by somatic mosaicism, constitutive mutation is lethal and cases are exclusively or predominantly mosaic. Evidence: TAS. (OMIM:607785)
- Juvenile myelomonocytic leukemia (HP:0012209): Juvenile myelomonocytic leukemia (JMML) is a lethal myeloproliferative disease of young childhood characterized clinically by overproduction of myelomonocytic cells and by the in vitro phenotype of hematopoietic progenitor hypersensitivity to granulocyte-macrophage colony-stimulating factor. Evidence: PCS. Onset: Infantile onset (HP:0003593). (PMID:25939664)
- Autosomal dominant inheritance (HP:0000006): A mode of inheritance that is observed for traits related to a gene encoded on one of the autosomes (i.e., the human chromosomes 1-22) in which a trait manifests in heterozygotes. In the context of medical genetics, an autosomal dominant disorder is caused when a single copy of the mutant allele is present. Males and females are affected equally, and can both transmit the disorder with a risk of 50% for each child of inheriting the mutant allele. Evidence: PCS. (PMID:25939664)